- Abnormality of the immune system (HP:0002715): An abnormality of the immune system. Evidence: IEA. (OMIM:272370)
- Autosomal recessive inheritance (HP:0000007): A mode of inheritance that is observed for traits related to a gene encoded on one of the autosomes (i.e., the human chromosomes 1-22) in which a trait manifests in individuals with two pathogenic alleles, either homozygotes (two copies of the same mutant allele) or compound heterozygotes (whereby each copy of a gene has a distinct mutant allele). Evidence: IEA. (OMIM:272370)
These phenotypes are associated with the disease SUSCEPTIBILITY TO LYSIS BY ALLOREACTIVE NATURAL KILLER CELLS (OMIM:272370).